Phenotypes associated with the disease pulmonic stenosis, atrial septal defect, and unique electrocardiographic abnormalities (OMIM:178650):
- Abnormal EKG (HP:0003115): Abnormal rhythm of the heart. Evidence: TAS. (OMIM:178650)
- Secundum atrial septal defect (HP:0001684): A kind of atrial septum defect arising from an enlarged foramen ovale, inadequate growth of the septum secundum, or excessive absorption of the septum primum. Evidence: TAS. (OMIM:178650)
- Pulmonic stenosis (HP:0001642): A narrowing of the right ventricular outflow tract that can occur at the pulmonary valve (valvular stenosis), below the pulmonary valve (infundibular stenosis), or above the pulmonary valve (supravalvar stenosis). Evidence: TAS. (OMIM:178650)
- Autosomal dominant inheritance (HP:0000006): A mode of inheritance that is observed for traits related to a gene encoded on one of the autosomes (i.e., the human chromosomes 1-22) in which a trait manifests in heterozygotes. In the context of medical genetics, an autosomal dominant disorder is caused when a single copy of the mutant allele is present. Males and females are affected equally, and can both transmit the disorder with a risk of 50% for each child of inheriting the mutant allele. Evidence: TAS. (OMIM:178650)